Phenotypes associated with the disease striae distensae, familial (OMIM:185200):
- Striae distensae (HP:0001065): Thinned, erythematous, depressed bands of atrophic skin. Initially, striae appear as flattened and thinned, pinkish linear regions of the skin. Striae tend to enlarge in length and become reddish or purplish. Later, striae tend to appear as white, depressed bands that are parallel to the lines of skin tension. Striae distensae occur most often in areas that have been subject to distension such as the lower back, buttocks, thighs, breast, abdomen, and shoulders. Evidence: TAS. (OMIM:185200)
- Autosomal dominant inheritance (HP:0000006): A mode of inheritance that is observed for traits related to a gene encoded on one of the autosomes (i.e., the human chromosomes 1-22) in which a trait manifests in heterozygotes. In the context of medical genetics, an autosomal dominant disorder is caused when a single copy of the mutant allele is present. Males and females are affected equally, and can both transmit the disorder with a risk of 50% for each child of inheriting the mutant allele. Evidence: TAS. (OMIM:185200)